Phenotypes associated with the disease Palatal anomalies-widely spaced teeth-facial dysmorphism-developmental delay syndrome (ORPHA:477993):
- Abnormal palate morphology (HP:0000174): Any abnormality of the palate, i.e., of roof of the mouth. Evidence: TAS. Frequency: Frequent (HP:0040282). (ORPHA:477993)
- Thin upper lip vermilion (HP:0000219): Height of the vermilion of the upper lip in the midline more than 2 SD below the mean. Alternatively, an apparently reduced height of the vermilion of the upper lip in the frontal view (subjective). Evidence: TAS. Frequency: Frequent (HP:0040282). (ORPHA:477993)
- Wide nasal bridge (HP:0000431): Increased breadth of the nasal bridge (and with it, the nasal root). Evidence: TAS. Frequency: Frequent (HP:0040282). (ORPHA:477993)
- Strabismus (HP:0000486): A misalignment of the eyes so that the visual axes deviate from bifoveal fixation. The classification of strabismus may be based on a number of features including the relative position of the eyes, whether the deviation is latent or manifest, intermittent or constant, concomitant or otherwise and according to the age of onset and the relevance of any associated refractive error. Evidence: TAS. Frequency: Frequent (HP:0040282). (ORPHA:477993)
- Downslanted palpebral fissures (HP:0000494): The palpebral fissure inclination is more than two standard deviations below the mean. Evidence: TAS. Frequency: Frequent (HP:0040282). (ORPHA:477993)
- Exotropia (HP:0000577): A form of strabismus with one or both eyes deviated outward. Evidence: TAS. Frequency: Frequent (HP:0040282). (ORPHA:477993)
- Widely spaced teeth (HP:0000687): Increased spaces (diastemata) between most of the teeth in the same dental arch. Evidence: TAS. Frequency: Frequent (HP:0040282). (ORPHA:477993)
- Delayed speech and language development (HP:0000750): A degree of language development that is significantly below the norm for a child of a specified age. Evidence: TAS. Frequency: Frequent (HP:0040282). (ORPHA:477993)
- Brachydactyly (HP:0001156): Digits that appear disproportionately short compared to the hand/foot. The word brachydactyly is used here to describe a series distinct patterns of shortened digits (brachydactyly types A-E). This is the sense used here. Evidence: TAS. Frequency: Frequent (HP:0040282). (ORPHA:477993)
- Hypotonia (HP:0001252): Hypotonia is an abnormally low muscle tone (the amount of tension or resistance to movement in a muscle). Even when relaxed, muscles have a continuous and passive partial contraction which provides some resistance to passive stretching. Hypotonia thus manifests as diminished resistance to passive stretching. Hypotonia is not the same as muscle weakness, although the two conditions can co-exist. Evidence: TAS. Frequency: Frequent (HP:0040282). (ORPHA:477993)
- Global developmental delay (HP:0001263): A delay in the achievement of motor or mental milestones in the domains of development of a child, including motor skills, speech and language, cognitive skills, and social and emotional skills. This term should only be used to describe children younger than five years of age. Evidence: TAS. Frequency: Frequent (HP:0040282). (ORPHA:477993)
- Abnormality of canine (HP:0011078): An abnormality of canine tooth. Evidence: TAS. Frequency: Frequent (HP:0040282). (ORPHA:477993)
- Prominent forehead (HP:0011220): Forward prominence of the entire forehead, due to protrusion of the frontal bone. Evidence: TAS. Frequency: Frequent (HP:0040282). (ORPHA:477993)
- Delayed ability to walk (HP:0031936): A failure to achieve the ability to walk at an appropriate developmental stage. Most children learn to walk in a series of stages, and learn to walk short distances independently between 12 and 15 months. Evidence: TAS. Frequency: Frequent (HP:0040282). (ORPHA:477993)
- Cryptorchidism (HP:0000028): Testis in inguinal canal. That is, absence of one or both testes from the scrotum owing to failure of the testis or testes to descend through the inguinal canal to the scrotum. Evidence: TAS. Frequency: Occasional (HP:0040283). (ORPHA:477993)
- Chordee (HP:0000041): A congenital anomaly of the penis characterized by ventral (i.e., downward), lateral, or ventrolateral curvature of the shaft and glans penis of more than 30 degrees. Evidence: TAS. Frequency: Occasional (HP:0040283). (ORPHA:477993)
- Hypospadias (HP:0000047): Abnormal position of urethral meatus on the ventral penile shaft (underside) characterized by displacement of the urethral meatus from the tip of the glans penis to the ventral surface of the penis, scrotum, or perineum. Evidence: TAS. Frequency: Occasional (HP:0040283). (ORPHA:477993)
- Macrocephaly (HP:0000256): Occipitofrontal (head) circumference greater than 97th centile compared to appropriate, age matched, sex-matched normal standards. Alternatively, a apparently increased size of the cranium. Evidence: TAS. Frequency: Occasional (HP:0040283). (ORPHA:477993)
- Hypertelorism (HP:0000316): Interpupillary distance more than 2 SD above the mean (alternatively, the appearance of an increased interpupillary distance or widely spaced eyes). Evidence: TAS. Frequency: Occasional (HP:0040283). (ORPHA:477993)
- Anteverted nares (HP:0000463): Anteriorly-facing nostrils viewed with the head in the Frankfurt horizontal and the eyes of the observer level with the eyes of the subject. This gives the appearance of an upturned nose (upturned nasal tip). Evidence: TAS. Frequency: Occasional (HP:0040283). (ORPHA:477993)
- Blue sclerae (HP:0000592): An abnormal bluish coloration of the sclera. Evidence: TAS. Frequency: Occasional (HP:0040283). (ORPHA:477993)
- Oculomotor apraxia (HP:0000657): Ocular motor apraxia is a deficiency in voluntary, horizontal, lateral, fast eye movements (saccades) with retention of slow pursuit movements. The inability to follow objects visually is often compensated by head movements. There may be decreased smooth pursuit, and cancelation of the vestibulo-ocular reflex. Evidence: TAS. Frequency: Occasional (HP:0040283). (ORPHA:477993)
- Synophrys (HP:0000664): Meeting of the medial eyebrows in the midline. Evidence: TAS. Frequency: Occasional (HP:0040283). (ORPHA:477993)
- Hypertrichosis (HP:0000998): Hypertrichosis is increased hair growth that is abnormal in quantity or location. Evidence: TAS. Frequency: Occasional (HP:0040283). (ORPHA:477993)
- Tapered finger (HP:0001182): The gradual reduction in girth of the finger from proximal to distal. Evidence: TAS. Frequency: Occasional (HP:0040283). (ORPHA:477993)
- Bilateral ptosis (HP:0001488). Evidence: TAS. Frequency: Occasional (HP:0040283). (ORPHA:477993)
- Patent foramen ovale (HP:0001655): Failure of the foramen ovale to seal postnatally, leaving a potential conduit between the left and right cardiac atria. Evidence: TAS. Frequency: Occasional (HP:0040283). (ORPHA:477993)
- Hypoplastic toenails (HP:0001800): Underdevelopment of the toenail. Evidence: TAS. Frequency: Occasional (HP:0040283). (ORPHA:477993)
- Hypoplasia of the corpus callosum (HP:0002079): Underdevelopment of the corpus callosum. Evidence: TAS. Frequency: Occasional (HP:0040283). (ORPHA:477993)
- Clonus (HP:0002169): A series of rhythmic and involuntary muscle contractions (at a frequency of about 5 to 7 Hz) that occur in response to an abruptly applied and sustained stretch. Evidence: TAS. Frequency: Occasional (HP:0040283). (ORPHA:477993)
- Sparse scalp hair (HP:0002209): Decreased number of hairs per unit area of skin of the scalp. Evidence: TAS. Frequency: Occasional (HP:0040283). (ORPHA:477993)
- Supernumerary nipple (HP:0002558): Presence of more than two nipples. Evidence: TAS. Frequency: Occasional (HP:0040283). (ORPHA:477993)
- Clinodactyly of the 5th finger (HP:0004209): Clinodactyly refers to a bending or curvature of the fifth finger in the radial direction (i.e., towards the 4th finger). Evidence: TAS. Frequency: Occasional (HP:0040283). (ORPHA:477993)
- Lower limb hypertonia (HP:0006895). Evidence: TAS. Frequency: Occasional (HP:0040283). (ORPHA:477993)
- Short thumb (HP:0009778): Hypoplasia (congenital reduction in size) of the thumb. Evidence: TAS. Frequency: Occasional (HP:0040283). (ORPHA:477993)
- High anterior hairline (HP:0009890): Distance between the hairline (trichion) and the glabella (the most prominent point on the frontal bone above the root of the nose), in the midline, more than two SD above the mean. Alternatively, an apparently increased distance between the hairline and the glabella. Evidence: TAS. Frequency: Occasional (HP:0040283). (ORPHA:477993)
- Narrow nasal tip (HP:0011832): Decrease in width of the nasal tip. Evidence: TAS. Frequency: Occasional (HP:0040283). (ORPHA:477993)
- Enlarged cerebellum (HP:0012081): An abnormally increased size of the cerebellum compared to other brain structures. Evidence: TAS. Frequency: Occasional (HP:0040283). (ORPHA:477993)
- Cerebral white matter hypoplasia (HP:0012430): Underdevelopment of the cerebral white matter. Evidence: TAS. Frequency: Occasional (HP:0040283). (ORPHA:477993)
- Delayed myelination (HP:0012448): Delayed myelination. Evidence: TAS. Frequency: Occasional (HP:0040283). (ORPHA:477993)
- Colpocephaly (HP:0030048): Colpocephaly is an anatomic finding in the brain manifested by occipital horns that are disproportionately enlarged in comparison with other parts of the lateral ventricles. Evidence: TAS. Frequency: Occasional (HP:0040283). (ORPHA:477993)
- Sparse eyebrow (HP:0045075): Decreased density/number of eyebrow hairs. Evidence: TAS. Frequency: Occasional (HP:0040283). (ORPHA:477993)